- Short stature (HP:0004322): A height below that which is expected according to age and gender norms. Although there is no universally accepted definition of short stature, many refer to "short stature" as height more than 2 standard deviations below the mean for age and gender (or below the 3rd percentile for age and gender dependent norms). Evidence: IEA. (OMIM:270460)
- Ventricular septal defect (HP:0001629): A hole between the two bottom chambers (ventricles) of the heart. The defect is centered around the most superior aspect of the ventricular septum. Evidence: IEA. (OMIM:270460)
- Narrow mouth (HP:0000160): Distance between the commissures of the mouth more than 2 SD below the mean. Alternatively, an apparently decreased width of the oral aperture (subjective). Evidence: IEA. (OMIM:270460)
- High axial triradius (HP:0001042). Evidence: IEA. (OMIM:270460)
- Autosomal recessive inheritance (HP:0000007): A mode of inheritance that is observed for traits related to a gene encoded on one of the autosomes (i.e., the human chromosomes 1-22) in which a trait manifests in individuals with two pathogenic alleles, either homozygotes (two copies of the same mutant allele) or compound heterozygotes (whereby each copy of a gene has a distinct mutant allele). Evidence: IEA. (OMIM:270460)
- Round face (HP:0000311): The facial appearance is more circular than usual as viewed from the front. Evidence: IEA. (OMIM:270460)
- Depressed nasal bridge (HP:0005280): Posterior positioning of the nasal root in relation to the overall facial profile for age. Evidence: IEA. (OMIM:270460)
- Intellectual disability (HP:0001249): The term intellectual disability or intellectual developmental disorder is used to describe significantly sub-average intellectual and adaptive functioning based on clinical assessment and as measured by individually administered, appropriately normed, standardized and validated tests of intellectual functioning and adaptive behavior, with onset during the developmental period from infancy through adolescence. Evidence: IEA. (OMIM:270460)
These phenotypes are associated with the disease congenital heart defect-round face-developmental delay syndrome (OMIM:270460).